Phenotypes associated with the disease interventricular septum aneurysm (OMIM:105805):
- Vascular dilatation (HP:0002617): An abnormal increase in the diameter of an artery or vein, either as a diffuse dilatation or as a localized, sac-like outpouching of the vessel wall (aneurysm). Evidence: IEA. (OMIM:105805)
- Abnormal ventricular septum morphology (HP:0010438): A structural abnormality of the interventricular septum. Evidence: IEA. (OMIM:105805)
- Autosomal dominant inheritance (HP:0000006): A mode of inheritance that is observed for traits related to a gene encoded on one of the autosomes (i.e., the human chromosomes 1-22) in which a trait manifests in heterozygotes. In the context of medical genetics, an autosomal dominant disorder is caused when a single copy of the mutant allele is present. Males and females are affected equally, and can both transmit the disorder with a risk of 50% for each child of inheriting the mutant allele. Evidence: IEA. (OMIM:105805)